Phenotypes associated with the disease intellectual developmental disorder with ocular anomalies and distinctive facial features (OMIM:620086):
- Epicanthus (HP:0000286): A fold of skin starting above the medial aspect of the upper eyelid and arching downward to cover, pass in front of and lateral to the medial canthus. Evidence: PCS. Frequency: 4/4. (PMID:36067766)
- Narrow forehead (HP:0000341): Width of the forehead or distance between the frontotemporales is more than two standard deviations below the mean (objective); or apparently narrow intertemporal region (subjective). Evidence: PCS. Frequency: 4/4. (PMID:36067766)
- Upslanted palpebral fissure (HP:0000582): The palpebral fissure inclination is more than two standard deviations above the mean for age (objective); or, the inclination of the palpebral fissure is greater than typical for age. Evidence: PCS. Frequency: 4/4. (PMID:36067766)
- Microcephaly (HP:0000252): Head circumference below 2 standard deviations below the mean for age and gender. Evidence: PCS. Frequency: 2/5. (PMID:36067766)
- Mild intellectual disability (HP:0001256): Mild intellectual disability (ID) is defined as a type of ID characterized by mildly sub-average adaptive functioning and intellectual functioning, with an intelligence quotient (IQ) the range of 50-69. Evidence: PCS. Frequency: 3/3. (PMID:36067766)
- Seizure (HP:0001250): A seizure is an intermittent abnormality of nervous system physiology characterized by a transient occurrence of signs and/or symptoms due to abnormal excessive or synchronous neuronal activity in the brain. Evidence: PCS. Frequency: 1/5. (PMID:36067766)
- Global developmental delay (HP:0001263): A delay in the achievement of motor or mental milestones in the domains of development of a child, including motor skills, speech and language, cognitive skills, and social and emotional skills. This term should only be used to describe children younger than five years of age. Evidence: PCS. Frequency: 5/5. (PMID:36067766)
- Infantile onset (HP:0003593): Onset of signs or symptoms of disease between 28 days to one year of life. Evidence: PCS. Frequency: 5/5. (PMID:36067766)
- Iris cyst (HP:0011523): An iris cyst is composed of a single cell layer of epithelium and is filled with fluid. Evidence: PCS. Frequency: 1/5. (PMID:36067766)
- Nystagmus (HP:0000639): Rhythmic, involuntary oscillations of one or both eyes related to abnormality in fixation, conjugate gaze, or vestibular mechanisms. Evidence: PCS. Frequency: 3/5. (PMID:36067766)
- Sensorineural hearing impairment (HP:0000407): A type of hearing impairment in one or both ears related to an abnormal functionality of the cochlear nerve. Evidence: PCS. Frequency: 2/4. (PMID:36067766)
- Autistic behavior (HP:0000729): Persistent deficits in social interaction and communication and interaction as well as a markedly restricted repertoire of activity and interest as well as repetitive patterns of behavior. Evidence: PCS. Frequency: 2/3. (PMID:36067766)
- Ptosis (HP:0000508): The upper eyelid margin is positioned 3 mm or more lower than usual and covers the superior portion of the iris (objective); or, the upper lid margin obscures at least part of the pupil (subjective). Evidence: PCS. Frequency: 2/5. (PMID:36067766)
- Hypoplasia of the fovea (HP:0007750): Underdevelopment of the fovea centralis. Evidence: PCS. Frequency: 1/5. (PMID:36067766)
- Optic atrophy (HP:0000648): Atrophy of the optic nerve. Optic atrophy results from the death of the retinal ganglion cell axons that comprise the optic nerve and manifesting as a pale optic nerve on fundoscopy. Evidence: PCS. Frequency: 1/5. (PMID:36067766)
- Autosomal dominant inheritance (HP:0000006): A mode of inheritance that is observed for traits related to a gene encoded on one of the autosomes (i.e., the human chromosomes 1-22) in which a trait manifests in heterozygotes. In the context of medical genetics, an autosomal dominant disorder is caused when a single copy of the mutant allele is present. Males and females are affected equally, and can both transmit the disorder with a risk of 50% for each child of inheriting the mutant allele. Evidence: PCS. (PMID:36067766)